Phenotypes associated with the disease malignant mesothelioma (OMIM:156240):
- Typified by somatic mosaicism (HP:0001442): Description of conditions in which affected individuals typically display somatic mosaicism, i.e., genetically distinct populations of somatic cells in a given organism caused by DNA mutations, epigenetic alterations of DNA, chromosomal abnormalities or the spontaneous reversion of inherited mutations. In many conditions typified by somatic mosaicism, constitutive mutation is lethal and cases are exclusively or predominantly mosaic. Evidence: TAS. (OMIM:156240)
- Malignant mesothelioma (HP:0100001): Malignant mesothelioma is a form of cancer that originates from the cells of the mesothelium, a thin tissue layer surrounding the body's internal organs. Malignant mesothelioma is almost exclusively caused by asbestos exposure, pleural mesothelioma being the most common form, affecting the lining of the lungs called the pleura. Other forms such as perioneal-, percardial- or testicular- mesothelioma are much rarer. Evidence: IEA. (OMIM:156240)